Phenotypes associated with the disease goiter, multinodular 1, with or without Sertoli-Leydig cell tumors (OMIM:138800):
- Papillary thyroid carcinoma (HP:0002895): The presence of a papillary adenocarcinoma of the thyroid gland. Evidence: IEA. (OMIM:138800)
- Euthyroid multinodular goiter (HP:0000866). Evidence: IEA. (OMIM:138800)
- Autosomal dominant inheritance (HP:0000006): A mode of inheritance that is observed for traits related to a gene encoded on one of the autosomes (i.e., the human chromosomes 1-22) in which a trait manifests in heterozygotes. In the context of medical genetics, an autosomal dominant disorder is caused when a single copy of the mutant allele is present. Males and females are affected equally, and can both transmit the disorder with a risk of 50% for each child of inheriting the mutant allele. Evidence: IEA. (OMIM:138800)